Phenotypes associated with the disease ectodermal dysplasia with adrenal cyst (OMIM:129550):
- Abnormality of the endocrine system (HP:0000818): An abnormality of the endocrine system. Evidence: IEA. (OMIM:129550)
- Delayed eruption of teeth (HP:0000684): Delayed tooth eruption, which can be defined as tooth eruption more than 2 SD beyond the mean eruption age. Evidence: IEA. (OMIM:129550)
- Nail dysplasia (HP:0002164): The presence of developmental dysplasia of the nail. Evidence: IEA. (OMIM:129550)
- Breast hypoplasia (HP:0003187): Underdevelopment of the breast. Evidence: IEA. (OMIM:129550)
- Ectodermal dysplasia (HP:0000968): Ectodermal dysplasia is a group of conditions in which there is abnormal development of the skin, hair, nails, teeth, or sweat glands. Evidence: IEA. (OMIM:129550)
- Hypohidrosis (HP:0000966): Abnormally diminished capacity to sweat. Evidence: IEA. (OMIM:129550)
- Hypoplastic nipples (HP:0002557): Underdevelopment of the nipple. Evidence: IEA. (OMIM:129550)
- Autosomal dominant inheritance (HP:0000006): A mode of inheritance that is observed for traits related to a gene encoded on one of the autosomes (i.e., the human chromosomes 1-22) in which a trait manifests in heterozygotes. In the context of medical genetics, an autosomal dominant disorder is caused when a single copy of the mutant allele is present. Males and females are affected equally, and can both transmit the disorder with a risk of 50% for each child of inheriting the mutant allele. Evidence: IEA. (OMIM:129550)